Phenotypes associated with the disease DIMPLES, FACIAL (OMIM:126100):
- Abnormality of the face (HP:0000271): An abnormality of the face. Evidence: IEA. (OMIM:126100)
- Autosomal dominant inheritance (HP:0000006): A mode of inheritance that is observed for traits related to a gene encoded on one of the autosomes (i.e., the human chromosomes 1-22) in which a trait manifests in heterozygotes. In the context of medical genetics, an autosomal dominant disorder is caused when a single copy of the mutant allele is present. Males and females are affected equally, and can both transmit the disorder with a risk of 50% for each child of inheriting the mutant allele. Evidence: IEA. (OMIM:126100)